Phenotypes associated with the disease MPDU1-CDG (ORPHA:79323):
- Type I transferrin isoform profile (HP:0003642): Abnormal transferrin isoform profile consistent with a type I congenital disorder of glycosylation. In the traditional nomenclature for congenital disorders of glycosylation, absence of entire glycans was designated type I, and loss of one or more monosaccharides as type II. Evidence: TAS. Frequency: Very frequent (HP:0040281). (ORPHA:79323)
- Severe intellectual disability (HP:0010864): Severe intellectual disability (ID) is defined as a type of ID characterized by severely sub-average adaptive functioning and intellectual functioning, with an intelligence quotient (IQ) the range of 20-34. Evidence: TAS. Frequency: Very frequent (HP:0040281). (ORPHA:79323)
- Abnormal circulating enzyme concentration or activity (HP:0012379): Concentration or activity of an enzyme is above or below the limits of normal in the blood circulation. Evidence: TAS. Frequency: Very frequent (HP:0040281). (ORPHA:79323)
- Floppy infant (HP:0008947): Floppiness/hypotonia is defined as reduced resistance to passive movement of joints. Physical examination of floppy/hypotonic infants shows head lag, lack of shoulder and elbow muscle contraction on traction response, inability to tighten the shoulder girdle muscles (or slipping through) when held under the axillae, scarf sign (when the arm is pulled to the opposite side, the arm wraps around the neck with the elbow crossing midline), hyperdorsiflexion of the feet, easy apposition of the thumb against the forearm, feet touching the cheek with ease and without discomfort, frog leg position, and inverted U sign on ventral suspension (head, arms, and legs hanging down without elbow or knee flexion and the trunk rounded in a dome shape). Evidence: TAS. Frequency: Frequent (HP:0040282). (ORPHA:79323)
- Thin vermilion border (HP:0000233): Height of the vermilion of the medial part of the lip more than 2 SD below the mean, or apparently reduced height of the vermilion of the lip in the frontal view. The vermilion is the red part of the lips (and confusingly, the vermilion itself is also often referred to as being equivalent the lips). Evidence: TAS. Frequency: Occasional (HP:0040283). (ORPHA:79323)
- Parietal bossing (HP:0000242): Parietal bossing is a marked prominence in the parietal region. Evidence: TAS. Frequency: Occasional (HP:0040283). (ORPHA:79323)
- Wide anterior fontanel (HP:0000260): Enlargement of the anterior fontanelle with respect to age-dependent norms. Evidence: TAS. Frequency: Occasional (HP:0040283). (ORPHA:79323)
- Optic atrophy (HP:0000648): Atrophy of the optic nerve. Optic atrophy results from the death of the retinal ganglion cell axons that comprise the optic nerve and manifesting as a pale optic nerve on fundoscopy. Evidence: TAS. Frequency: Occasional (HP:0040283). (ORPHA:79323)
- Renal cortical cysts (HP:0000803): Cysts of the cortex of the kidney. Evidence: TAS. Frequency: Occasional (HP:0040283). (ORPHA:79323)
- Decreased response to growth hormone stimulation test (HP:0000824): Insufficient responses to growth hormone (GH) provocation tests. GH deficiency is defined as a serum peak GH concentration less than 10 ng/mL on provocation with a combination of at least two separate stimulation tests. Evidence: TAS. Frequency: Occasional (HP:0040283). (ORPHA:79323)
- Eczematoid dermatitis (HP:0000964): Eczema is a form of dermatitis that is characterized by scaly, pruritic, erythematous lesions located on flexural surfaces. Evidence: TAS. Frequency: Occasional (HP:0040283). (ORPHA:79323)
- Seizure (HP:0001250): A seizure is an intermittent abnormality of nervous system physiology characterized by a transient occurrence of signs and/or symptoms due to abnormal excessive or synchronous neuronal activity in the brain. Evidence: TAS. Frequency: Occasional (HP:0040283). (ORPHA:79323)
- Hypertonia (HP:0001276): A condition in which there is increased muscle tone so that arms or legs, for example, are stiff and difficult to move. Evidence: TAS. Frequency: Occasional (HP:0040283). (ORPHA:79323)
- Ventriculomegaly (HP:0002119): An increase in size of the ventricular system of the brain. Evidence: TAS. Frequency: Occasional (HP:0040283). (ORPHA:79323)
- Hypsarrhythmia (HP:0002521): Hypsarrhythmia is abnormal interictal high amplitude waves and a background of irregular spikes. There is continuous (during wakefulness), high-amplitude (>200 Hz), generalized polymorphic slowing with no organized background and multifocal spikes demonstrated by electroencephalography (EEG). Evidence: TAS. Frequency: Occasional (HP:0040283). (ORPHA:79323)
- Elevated circulating creatine kinase activity (HP:0003236): The activity of creatine kinase in the blood circulation is above the upper limit of normal. Evidence: TAS. Frequency: Occasional (HP:0040283). (ORPHA:79323)
- Prominent frontal sinuses (HP:0005478). Evidence: TAS. Frequency: Occasional (HP:0040283). (ORPHA:79323)
- Undetectable visual evoked potentials (HP:0007965). Evidence: TAS. Frequency: Occasional (HP:0040283). (ORPHA:79323)
- Ichthyosis (HP:0008064): An abnormality of the skin characterized the presence of excessive amounts of dry surface scales on the skin resulting from an abnormality of keratinization. Evidence: TAS. Frequency: Occasional (HP:0040283). (ORPHA:79323)
- Absence of acoustic reflex (HP:0008529): Absence of the acoustic reflex, an involuntary contraction of the stapedius muscle that occurs in response to high-intensity sound stimuli. Evidence: TAS. Frequency: Occasional (HP:0040283). (ORPHA:79323)
- Feeding difficulties (HP:0011968): Impaired ability to eat related to problems gathering food and getting ready to suck, chew, or swallow it. Evidence: TAS. Frequency: Occasional (HP:0040283). (ORPHA:79323)
- Widened subarachnoid space (HP:0012704): An increase in size of the anatomic space between the arachnoid membrane and pia mater. Evidence: TAS. Frequency: Occasional (HP:0040283). (ORPHA:79323)
- Erythematous plaque (HP:0025474): A plaque (a solid, raised, plateau-like (flat-topped) lesion greater than 1 cm in diameter) with a red or reddish color often associated with inflammation or irritation. Evidence: TAS. Frequency: Occasional (HP:0040283). (ORPHA:79323)
- Decreased circulating insulin-like growth factor 1 concentration (HP:0030353): The concentration of insulin-like growth factor 1 (IGF1) in the blood circulation is below the lower limit of normal. Evidence: TAS. Frequency: Occasional (HP:0040283). (ORPHA:79323)
- Scaling skin (HP:0040189): Refers to the loss of the outer layer of the epidermis in large, scale-like flakes. Evidence: TAS. Frequency: Occasional (HP:0040283). (ORPHA:79323)
- Nasogastric tube feeding (HP:0040288): The condition of inability to eat normally treated by placement of a thin tube through the nose into the stomach that is then used to carry food. Evidence: TAS. Frequency: Occasional (HP:0040283). (ORPHA:79323)